Phenotypes associated with the disease Nodular regenerative hyperplasia of the liver (ORPHA:48372):
- Portal hypertension (HP:0001409): Increased pressure in the portal vein. Evidence: TAS. Frequency: Occasional (HP:0040283). (ORPHA:48372)
- Abnormality of the hepatic vasculature (HP:0006707): An abnormality of the hepatic vasculature. Evidence: TAS. Frequency: Very frequent (HP:0040281). (ORPHA:48372)